Phenotypes associated with the disease Kleine-Levin syndrome (OMIM:148840):
- Confusion (HP:0001289): Lack of clarity and coherence of thought, perception, understanding, or action. Evidence: IEA. (OMIM:148840)
- Vivid hallucination (HP:0006803): Perceptual experiences that are vivid, intense, and sensory in nature occur in the absence of corresponding stimuli from the external environment. Evidence: IEA. (OMIM:148840)
- Polyphagia (HP:0002591): A neurological anomaly with gross overeating associated with an abnormally strong desire or need to eat. Evidence: IEA. (OMIM:148840)
- Episodic hypersomnia (HP:0007200): Recurrent episodes of hypersomnia (sleeping 16 or more hours a day) over a period of days or weeks. Evidence: IEA. (OMIM:148840)
- Autosomal dominant inheritance (HP:0000006): A mode of inheritance that is observed for traits related to a gene encoded on one of the autosomes (i.e., the human chromosomes 1-22) in which a trait manifests in heterozygotes. In the context of medical genetics, an autosomal dominant disorder is caused when a single copy of the mutant allele is present. Males and females are affected equally, and can both transmit the disorder with a risk of 50% for each child of inheriting the mutant allele. Evidence: IEA. (OMIM:148840)